- Autosomal recessive inheritance (HP:0000007): A mode of inheritance that is observed for traits related to a gene encoded on one of the autosomes (i.e., the human chromosomes 1-22) in which a trait manifests in individuals with two pathogenic alleles, either homozygotes (two copies of the same mutant allele) or compound heterozygotes (whereby each copy of a gene has a distinct mutant allele). Evidence: IEA. (OMIM:264060)
- Abnormality of the cardiovascular system (HP:0001626): Any abnormality of the cardiovascular system. Evidence: IEA. (OMIM:264060)
- Abnormality of the eye (HP:0000478): Any abnormality of the eye, including location, spacing, and intraocular abnormalities. Evidence: IEA. (OMIM:264060)
These phenotypes are associated with the disease Prepapillary vascular loops (OMIM:264060).